- Hypothyroidism (HP:0000821): Deficiency of thyroid hormone. Evidence: TAS. Frequency: Occasional (HP:0040283). (ORPHA:1195)
- Arthritis (HP:0001369): Inflammation of a joint. Evidence: TAS. Frequency: Occasional (HP:0040283). (ORPHA:1195)
- Abnormality of the cardiovascular system (HP:0001626): Any abnormality of the cardiovascular system. Evidence: TAS. Frequency: Occasional (HP:0040283). (ORPHA:1195)
- Abnormality of the pancreas (HP:0001732): An abnormality of the pancreas. Evidence: TAS. Frequency: Occasional (HP:0040283). (ORPHA:1195)
- Anemia (HP:0001903): A reduction in erythrocytes volume or hemoglobin concentration. Evidence: TAS. Frequency: Very frequent (HP:0040281). (ORPHA:1195)
- Recurrent infections (HP:0002719): Increased susceptibility to infections as manifested by repeated bouts of infection. Evidence: TAS. Frequency: Frequent (HP:0040282). (ORPHA:1195)
These phenotypes are associated with the disease Congenital atransferrinemia (ORPHA:1195).